Phenotypes associated with the disease Pleural mesothelioma (ORPHA:50251):
- Pleural effusion (HP:0002202): The presence of an excessive amount of fluid in the pleural cavity. Evidence: TAS. Frequency: Very frequent (HP:0040281). (ORPHA:50251)
- Abnormal thorax morphology (HP:0000765): Any abnormality of the thorax (the region of the body formed by the sternum, the thoracic vertebrae and the ribs). Evidence: TAS. Frequency: Frequent (HP:0040282). (ORPHA:50251)
- Weight loss (HP:0001824): Reduction of total body weight. Evidence: TAS. Frequency: Frequent (HP:0040282). (ORPHA:50251)
- Dyspnea (HP:0002094): Difficult or labored breathing. Dyspnea is a subjective feeling only the patient can rate, e.g., on a Borg scale. Evidence: TAS. Frequency: Frequent (HP:0040282). (ORPHA:50251)
- Respiratory distress (HP:0002098): Respiratory distress is objectively observable as the physical or emotional consequences from the experience of dyspnea. The physical presentation of respiratory distress is generally referred to as labored breathing, while the sensation of respiratory distress is called shortness of breath or dyspnea. Evidence: TAS. Frequency: Frequent (HP:0040282). (ORPHA:50251)
- Abnormal pleura morphology (HP:0002103): An abnormality of the pulmonary pleura, the thin, transparent membrane which covers the lungs and lines the inside of the chest walls. Evidence: TAS. Frequency: Frequent (HP:0040282). (ORPHA:50251)
- Cough (HP:0012735): A sudden, audible expulsion of air from the lungs through a partially closed glottis, preceded by inhalation. Evidence: TAS. Frequency: Frequent (HP:0040282). (ORPHA:50251)
- Constitutional symptom (HP:0025142): A symptom or manifestation indicating a systemic or general effect of a disease and that may affect the general well-being or status of an individual. Evidence: TAS. Frequency: Frequent (HP:0040282). (ORPHA:50251)
- Chest pain (HP:0100749): An unpleasant sensation characterized by physical discomfort (such as pricking, throbbing, or aching) localized to the chest. Evidence: TAS. Frequency: Frequent (HP:0040282). (ORPHA:50251)
- Dysphagia (HP:0002015): Difficulty in swallowing. Evidence: TAS. Frequency: Occasional (HP:0040283). (ORPHA:50251)
- Abnormal lung morphology (HP:0002088): Any structural anomaly of the lung. Evidence: TAS. Frequency: Occasional (HP:0040283). (ORPHA:50251)
- Hepatomegaly (HP:0002240): Abnormally increased size of the liver. Evidence: TAS. Frequency: Occasional (HP:0040283). (ORPHA:50251)
- Lymphadenopathy (HP:0002716): Enlargement (swelling) of a lymph node. Evidence: TAS. Frequency: Occasional (HP:0040283). (ORPHA:50251)
- Abnormal respiratory system physiology (HP:0002795): Abnormal function of the respiratory system. Evidence: TAS. Frequency: Occasional (HP:0040283). (ORPHA:50251)
- Fourth cranial nerve palsy (HP:0007011): Paralysis of the fourth cranial (trochlear) nerve manifested as weakness of the superior oblique muscle which causes vertical diplopia that is maximal when the affected eye is adducted and directed inferiorly. Evidence: TAS. Frequency: Occasional (HP:0040283). (ORPHA:50251)
- Abnormal cardiovascular system physiology (HP:0011025): Abnormal functionality of the cardiovascular system. Evidence: TAS. Frequency: Occasional (HP:0040283). (ORPHA:50251)
- Obstruction of the superior vena cava (HP:0031041): Blockage of blood flow through the superior vena cava (SVC). Because the venous drainage from the upper extremities, upper thorax and head is obstructed, SVC obstruction presents with symptoms related to engorgement of these areas. Both the degree of SVC compromise and the extent of collateral veins determine the varied clinical presentation, which can be as mild as slight facial and upper extremity edema or as dire as intracranial swelling, seizures, hemodynamic instability and tracheal obstruction. Evidence: TAS. Frequency: Occasional (HP:0040283). (ORPHA:50251)